Phenotypes associated with the disease idiopathic hypereosinophilic syndrome (OMIM:607685):
- Pulmonary infiltrates (HP:0002113). Evidence: IEA. (OMIM:607685)
- Increased total eosinophil count (HP:0001880): Increased count of eosinophils in the blood. Evidence: TAS. (OMIM:607685)
- Typified by somatic mosaicism (HP:0001442): Description of conditions in which affected individuals typically display somatic mosaicism, i.e., genetically distinct populations of somatic cells in a given organism caused by DNA mutations, epigenetic alterations of DNA, chromosomal abnormalities or the spontaneous reversion of inherited mutations. In many conditions typified by somatic mosaicism, constitutive mutation is lethal and cases are exclusively or predominantly mosaic. Evidence: IEA. (OMIM:607685)
- Hepatomegaly (HP:0002240): Abnormally increased size of the liver. Evidence: IEA. (OMIM:607685)
- Abnormality of the nervous system (HP:0000707): An abnormality of the nervous system. Evidence: IEA. (OMIM:607685)
- Restrictive cardiomyopathy (HP:0001723): Restrictive left ventricular physiology is characterized by a pattern of ventricular filling in which increased stiffness of the myocardium causes ventricular pressure to rise precipitously with only small increases in volume, defined as restrictive ventricular physiology in the presence of normal or reduced diastolic volumes (of one or both ventricles), normal or reduced systolic volumes, and normal ventricular wall thickness. Evidence: IEA. (OMIM:607685)
- Pruritus (HP:0000989): Pruritus is an itch or a sensation that makes a person want to scratch. This term refers to an abnormally increased disposition to experience pruritus. Evidence: IEA. (OMIM:607685)
- Venous thrombosis (HP:0004936): Formation of a blood clot (thrombus) inside a vein, causing the obstruction of blood flow. Evidence: IEA. (OMIM:607685)
- Endocardial fibrosis (HP:0006685): The presence of excessive connective tissue in the endocardium. Evidence: IEA. (OMIM:607685)
- Sporadic (HP:0003745): Cases of the disease in question occur without a previous family history, i.e., as isolated cases without being transmitted from a parent and without other siblings being affected. Evidence: IEA. (OMIM:607685)
- Splenomegaly (HP:0001744): Abnormal increased size of the spleen. Evidence: IEA. (OMIM:607685)
- Myalgia (HP:0003326): Pain in muscle. Evidence: IEA. (OMIM:607685)
- Myeloproliferative disorder (HP:0005547): Proliferation (excess production) of hemopoietically active tissue or of tissue which has embryonic hemopoietic potential. Evidence: TAS. (OMIM:607685)